- Porokeratosis (HP:0200044): A clonal disorder of keratinization with one or multiple atrophic patches surrounded by a clinically and histologically distinctive hyperkeratotic ridgelike border called the cornoid lamella. Evidence: TAS. Frequency: Very frequent (HP:0040281). (ORPHA:79152)
- Cutaneous photosensitivity (HP:0000992): An increased sensitivity of the skin to light. Photosensitivity may result in a rash upon exposure to the sun (which is known as photodermatosis). Photosensitivity can be diagnosed by phototests in which light is shone on small areas of skin. Evidence: TAS. Frequency: Frequent (HP:0040282). (ORPHA:79152)
- Pruritus (HP:0000989): Pruritus is an itch or a sensation that makes a person want to scratch. This term refers to an abnormally increased disposition to experience pruritus. Evidence: TAS. Frequency: Occasional (HP:0040283). (ORPHA:79152)
- Squamous cell carcinoma (HP:0002860): The presence of squamous cell carcinoma of the skin. Evidence: TAS. Frequency: Occasional (HP:0040283). (ORPHA:79152)
These phenotypes are associated with the disease Disseminated superficial actinic porokeratosis (ORPHA:79152).